- Congenital onset (HP:0003577): A phenotypic abnormality that is present at birth. Evidence: PCS. Frequency: 8/8. (PMID:25601850)
- Sensorineural hearing impairment (HP:0000407): A type of hearing impairment in one or both ears related to an abnormal functionality of the cochlear nerve. Evidence: PCS. Frequency: 8/8. (PMID:25601850)
- Autosomal recessive inheritance (HP:0000007): A mode of inheritance that is observed for traits related to a gene encoded on one of the autosomes (i.e., the human chromosomes 1-22) in which a trait manifests in individuals with two pathogenic alleles, either homozygotes (two copies of the same mutant allele) or compound heterozygotes (whereby each copy of a gene has a distinct mutant allele). Evidence: PCS. (PMID:25601850)
These phenotypes are associated with the disease autosomal recessive nonsyndromic hearing loss 66 (OMIM:610212).